- Autosomal dominant inheritance (HP:0000006): A mode of inheritance that is observed for traits related to a gene encoded on one of the autosomes (i.e., the human chromosomes 1-22) in which a trait manifests in heterozygotes. In the context of medical genetics, an autosomal dominant disorder is caused when a single copy of the mutant allele is present. Males and females are affected equally, and can both transmit the disorder with a risk of 50% for each child of inheriting the mutant allele. Evidence: IEA. (OMIM:177350)
- Abnormality of the skin (HP:0000951): An abnormality of the skin. Evidence: IEA. (OMIM:177350)
These phenotypes are associated with the disease Pseudoatrophoderma colli (OMIM:177350).